Phenotypes associated with the disease anonychia-ectrodactyly (OMIM:106900):
- Ectodermal dysplasia (HP:0000968): Ectodermal dysplasia is a group of conditions in which there is abnormal development of the skin, hair, nails, teeth, or sweat glands. Evidence: IEA. (OMIM:106900)
- Aplasia of metacarpal bones (HP:0010048): Developmental defect associated with absence of one or more metacarpal bones. Evidence: IEA. (OMIM:106900)
- Split hand (HP:0001171): A condition in which middle parts of the hand (fingers and metacarpals) are missing giving a cleft appearance. The severity is very variable ranging from slightly hypoplastic middle fingers over absent middle fingers as far as oligo- or monodactyl hands. Evidence: IEA. (OMIM:106900)
- Autosomal dominant inheritance (HP:0000006): A mode of inheritance that is observed for traits related to a gene encoded on one of the autosomes (i.e., the human chromosomes 1-22) in which a trait manifests in heterozygotes. In the context of medical genetics, an autosomal dominant disorder is caused when a single copy of the mutant allele is present. Males and females are affected equally, and can both transmit the disorder with a risk of 50% for each child of inheriting the mutant allele. Evidence: IEA. (OMIM:106900)
- Anonychia (HP:0001798): Aplasia of the nail. Evidence: IEA. (OMIM:106900)